- Cryptorchidism (HP:0000028): Testis in inguinal canal. That is, absence of one or both testes from the scrotum owing to failure of the testis or testes to descend through the inguinal canal to the scrotum. Evidence: TAS. Frequency: Very frequent (HP:0040281). (ORPHA:3459)
- Thin upper lip vermilion (HP:0000219): Height of the vermilion of the upper lip in the midline more than 2 SD below the mean. Alternatively, an apparently reduced height of the vermilion of the upper lip in the frontal view (subjective). Evidence: TAS. Frequency: Very frequent (HP:0040281). (ORPHA:3459)
- Prominent supraorbital ridges (HP:0000336): Greater than average forward and/or lateral protrusion of the supraorbital portion of the frontal bones. Evidence: TAS. Frequency: Very frequent (HP:0040281). (ORPHA:3459)
- Micrognathia (HP:0000347): Developmental hypoplasia of the mandible. Evidence: TAS. Frequency: Very frequent (HP:0040281). (ORPHA:3459)
- Broad nasal tip (HP:0000455): Increase in width of the nasal tip. Evidence: TAS. Frequency: Very frequent (HP:0040281). (ORPHA:3459)
- Deeply set eye (HP:0000490): An eye that is more deeply recessed into the plane of the face than is typical. Evidence: TAS. Frequency: Very frequent (HP:0040281). (ORPHA:3459)
- Thick eyebrow (HP:0000574): Increased density/number and/or increased diameter of eyebrow hairs. Evidence: TAS. Frequency: Very frequent (HP:0040281). (ORPHA:3459)
- Emotional lability (HP:0000712): Unstable emotional experiences and frequent mood changes; emotions that are easily aroused, intense, and/or disproportionate to events and circumstances. Evidence: TAS. Frequency: Very frequent (HP:0040281). (ORPHA:3459)
- Gynecomastia (HP:0000771): Abnormal development of large mammary glands in males resulting in breast enlargement. Evidence: TAS. Frequency: Very frequent (HP:0040281). (ORPHA:3459)
- Tapered finger (HP:0001182): The gradual reduction in girth of the finger from proximal to distal. Evidence: TAS. Frequency: Very frequent (HP:0040281). (ORPHA:3459)
- Intellectual disability (HP:0001249): The term intellectual disability or intellectual developmental disorder is used to describe significantly sub-average intellectual and adaptive functioning based on clinical assessment and as measured by individually administered, appropriately normed, standardized and validated tests of intellectual functioning and adaptive behavior, with onset during the developmental period from infancy through adolescence. Evidence: TAS. Frequency: Very frequent (HP:0040281). (ORPHA:3459)
- Global developmental delay (HP:0001263): A delay in the achievement of motor or mental milestones in the domains of development of a child, including motor skills, speech and language, cognitive skills, and social and emotional skills. This term should only be used to describe children younger than five years of age. Evidence: TAS. Frequency: Very frequent (HP:0040281). (ORPHA:3459)
- Pes cavus (HP:0001761): An increase in height of the medial longitudinal arch of the foot that does not flatten on weight bearing (i.e., a distinctly hollow form of the sole of the foot when it is bearing weight). Evidence: TAS. Frequency: Very frequent (HP:0040281). (ORPHA:3459)
- Pes planus (HP:0001763): A foot where the longitudinal arch of the foot is in contact with the ground or floor when the individual is standing; or, in a patient lying supine, a foot where the arch is in contact with the surface of a flat board pressed against the sole of the foot by the examiner with a pressure similar to that expected from weight bearing; or, the height of the arch is reduced. Evidence: TAS. Frequency: Very frequent (HP:0040281). (ORPHA:3459)
- Short foot (HP:0001773): A measured foot length that is more than 2 SD below the mean for a newborn of 27 - 41 weeks gestation, or foot that is less than the 3rd centile for individuals from birth to 16 years of age (objective). Alternatively, a foot that appears disproportionately short (subjective). Evidence: TAS. Frequency: Very frequent (HP:0040281). (ORPHA:3459)
- Truncal obesity (HP:0001956): Obesity located preferentially in the trunk of the body as opposed to the extremities. Evidence: TAS. Frequency: Very frequent (HP:0040281). (ORPHA:3459)
- Abnormal facial shape (HP:0001999): An abnormal morphology (form) of the face or its components. Evidence: TAS. Frequency: Very frequent (HP:0040281). (ORPHA:3459)
- Poor speech (HP:0002465). Evidence: TAS. Frequency: Very frequent (HP:0040281). (ORPHA:3459)
- Short stature (HP:0004322): A height below that which is expected according to age and gender norms. Although there is no universally accepted definition of short stature, many refer to "short stature" as height more than 2 standard deviations below the mean for age and gender (or below the 3rd percentile for age and gender dependent norms). Evidence: TAS. Frequency: Very frequent (HP:0040281). (ORPHA:3459)
- Microtia (HP:0008551): Underdevelopment of the external ear. Evidence: TAS. Frequency: Very frequent (HP:0040281). (ORPHA:3459)
- Malar prominence (HP:0010620): Prominence of the malar process of the maxilla and infraorbital area appreciated in profile and from in front of the face. Evidence: TAS. Frequency: Very frequent (HP:0040281). (ORPHA:3459)
- Small hand (HP:0200055): Disproportionately small hand. Evidence: TAS. Frequency: Very frequent (HP:0040281). (ORPHA:3459)
- Hypogonadotropic hypogonadism (HP:0000044): Hypogonadotropic hypogonadism is characterized by reduced function of the gonads (testes in males or ovaries in females) and results from the absence of the gonadal stimulating pituitary hormones: follicle stimulating hormone (FSH) and luteinizing hormone (LH). Evidence: TAS. Frequency: Frequent (HP:0040282). (ORPHA:3459)
- Seizure (HP:0001250): A seizure is an intermittent abnormality of nervous system physiology characterized by a transient occurrence of signs and/or symptoms due to abnormal excessive or synchronous neuronal activity in the brain. Evidence: TAS. Frequency: Occasional (HP:0040283). (ORPHA:3459)
- Specific learning disability (HP:0001328): Impairment of certain skills such as reading or writing, coordination, self-control, or attention that interfere with the ability to learn. The impairment is not related to a global deficiency of intelligence. Evidence: TAS. Frequency: Occasional (HP:0040283). (ORPHA:3459)
These phenotypes are associated with the disease Wilson-Turner syndrome (ORPHA:3459).
The following phenotypes are NOT associated with this disease:
- Cataract (HP:0000518): A cataract is an opacity or clouding that develops in the crystalline lens of the eye or in its capsule. Evidence: TAS. (ORPHA:3459)
- Hypermetropia (HP:0000540): An abnormality of refraction characterized by the ability to see objects in the distance clearly, while objects nearby appear blurry. Evidence: TAS. (ORPHA:3459)
- Uplifted earlobe (HP:0009909): An abnormal orientation of the earlobes such that they point out- and upward. That is, the lateral surface of ear lobe faces superiorly. Evidence: TAS. (ORPHA:3459)